- Microcephaly (HP:0000252): Head circumference below 2 standard deviations below the mean for age and gender. Evidence: TAS. Frequency: Very frequent (HP:0040281). (ORPHA:818)
- Micrognathia (HP:0000347): Developmental hypoplasia of the mandible. Evidence: TAS. Frequency: Very frequent (HP:0040281). (ORPHA:818)
- Wide nasal bridge (HP:0000431): Increased breadth of the nasal bridge (and with it, the nasal root). Evidence: TAS. Frequency: Very frequent (HP:0040281). (ORPHA:818)
- Anteverted nares (HP:0000463): Anteriorly-facing nostrils viewed with the head in the Frankfurt horizontal and the eyes of the observer level with the eyes of the subject. This gives the appearance of an upturned nose (upturned nasal tip). Evidence: TAS. Frequency: Very frequent (HP:0040281). (ORPHA:818)
- Intellectual disability (HP:0001249): The term intellectual disability or intellectual developmental disorder is used to describe significantly sub-average intellectual and adaptive functioning based on clinical assessment and as measured by individually administered, appropriately normed, standardized and validated tests of intellectual functioning and adaptive behavior, with onset during the developmental period from infancy through adolescence. Evidence: TAS. Frequency: Very frequent (HP:0040281). (ORPHA:818)
- Hypotonia (HP:0001252): Hypotonia is an abnormally low muscle tone (the amount of tension or resistance to movement in a muscle). Even when relaxed, muscles have a continuous and passive partial contraction which provides some resistance to passive stretching. Hypotonia thus manifests as diminished resistance to passive stretching. Hypotonia is not the same as muscle weakness, although the two conditions can co-exist. Evidence: TAS. Frequency: Very frequent (HP:0040281). (ORPHA:818)
- Global developmental delay (HP:0001263): A delay in the achievement of motor or mental milestones in the domains of development of a child, including motor skills, speech and language, cognitive skills, and social and emotional skills. This term should only be used to describe children younger than five years of age. Evidence: TAS. Frequency: Very frequent (HP:0040281). (ORPHA:818)
- Growth delay (HP:0001510): A deficiency or slowing down of growth pre- and postnatally. Evidence: TAS. Frequency: Very frequent (HP:0040281). (ORPHA:818)
- Gastroesophageal reflux (HP:0002020): A condition in which the stomach contents leak backwards from the stomach into the esophagus through the lower esophageal sphincter. Evidence: TAS. Frequency: Very frequent (HP:0040281). (ORPHA:818)
- Short stature (HP:0004322): A height below that which is expected according to age and gender norms. Although there is no universally accepted definition of short stature, many refer to "short stature" as height more than 2 standard deviations below the mean for age and gender (or below the 3rd percentile for age and gender dependent norms). Evidence: TAS. Frequency: Very frequent (HP:0040281). (ORPHA:818)
- 2-3 toe syndactyly (HP:0004691): Syndactyly with fusion of toes two and three. Evidence: TAS. Frequency: Very frequent (HP:0040281). (ORPHA:818)
- Abnormal dental morphology (HP:0006482): An abnormality of the morphology of the tooth. Evidence: TAS. Frequency: Very frequent (HP:0040281). (ORPHA:818)
- Abnormal dermatoglyphics (HP:0007477): An abnormality of dermatoglyphs (fingerprints), which are present on fingers, palms, toes, and soles. Evidence: TAS. Frequency: Very frequent (HP:0040281). (ORPHA:818)
- Feeding difficulties in infancy (HP:0008872): Impaired feeding performance of an infant as manifested by difficulties such as weak and ineffective sucking, brief bursts of sucking, and falling asleep during sucking. There may be difficulties with chewing or maintaining attention. Evidence: TAS. Frequency: Very frequent (HP:0040281). (ORPHA:818)
- Elevated circulating 7-dehydrocholesterol concentration (HP:0010569): Concentration of 7-dehydrocholesterol in the blood circulation above the upper limit of normal. Evidence: TAS. Frequency: Very frequent (HP:0040281). (ORPHA:818)
- Increased nuchal translucency (HP:0010880): Nuchal translucency is the sonographic appearance of subcutaneous accumulation of liquid in the back of the fetal neck in the first trimester of pregnancy (11-14 gestational weeks of pregnancy). Evidence: TAS. Frequency: Very frequent (HP:0040281). (ORPHA:818)
- Cryptorchidism (HP:0000028): Testis in inguinal canal. That is, absence of one or both testes from the scrotum owing to failure of the testis or testes to descend through the inguinal canal to the scrotum. Evidence: TAS. Frequency: Frequent (HP:0040282). (ORPHA:818)
- Hypospadias (HP:0000047): Abnormal position of urethral meatus on the ventral penile shaft (underside) characterized by displacement of the urethral meatus from the tip of the glans penis to the ventral surface of the penis, scrotum, or perineum. Evidence: TAS. Frequency: Frequent (HP:0040282). (ORPHA:818)
- Ambiguous genitalia (HP:0000062): A genital phenotype that is not clearly assignable to a single gender. Ambiguous genitalia can be evaluated using the Prader scale: Prader 0: Normal female external genitalia. Prader 1: Female external genitalia with clitoromegaly. Prader 2: Clitoromegaly with partial labial fusion forming a funnel-shaped urogenital sinus. Prader 3: Increased phallic enlargement. Complete labioscrotal fusion forming a urogenital sinus with a single opening. Prader 4: Complete scrotal fusion with urogenital opening at the base or on the shaft of the phallus. Prader 5: Normal male external genitalia. The diagnosis of ambiguous genitalia is made for Prader 1-4. Evidence: TAS. Frequency: Frequent (HP:0040282). (ORPHA:818)
- Wide mouth (HP:0000154): Distance between the oral commissures more than 2 SD above the mean. Alternatively, an apparently increased width of the oral aperture (subjective). Evidence: TAS. Frequency: Frequent (HP:0040282). (ORPHA:818)
- Cleft palate (HP:0000175): Cleft palate is a developmental defect of the palate resulting from a failure of fusion of the palatine processes and manifesting as a separation of the roof of the mouth (soft and hard palate). Evidence: TAS. Frequency: Frequent (HP:0040282). (ORPHA:818)
- Gingival overgrowth (HP:0000212): Hyperplasia of the gingiva (that is, a thickening of the soft tissue overlying the alveolar ridge. The degree of thickening ranges from involvement of the interdental papillae alone to gingival overgrowth covering the entire tooth crown. Evidence: TAS. Frequency: Frequent (HP:0040282). (ORPHA:818)
- Long philtrum (HP:0000343): Distance between nasal base and midline upper lip vermilion border more than 2 SD above the mean. Alternatively, an apparently increased distance between nasal base and midline upper lip vermilion border. Evidence: TAS. Frequency: Frequent (HP:0040282). (ORPHA:818)
- Short neck (HP:0000470): Diminished length of the neck. Evidence: TAS. Frequency: Frequent (HP:0040282). (ORPHA:818)
- Ptosis (HP:0000508): The upper eyelid margin is positioned 3 mm or more lower than usual and covers the superior portion of the iris (objective); or, the upper lid margin obscures at least part of the pupil (subjective). Evidence: TAS. Frequency: Frequent (HP:0040282). (ORPHA:818)
- Autism (HP:0000717): Autism is a neurodevelopmental disorder characterized by impaired social interaction and communication, and by restricted and repetitive behavior. Autism begins in childhood. It is marked by the presence of markedly abnormal or impaired development in social interaction and communication and a markedly restricted repertoire of activity and interest. Manifestations of the disorder vary greatly depending on the developmental level and chronological age of the individual (DSM-IV). Evidence: TAS. Frequency: Frequent (HP:0040282). (ORPHA:818)
- Cutis marmorata (HP:0000965): A reticular discoloration of the skin with cyanotic (reddish-blue appearing) areas surrounding pale central areas due to dilation of capillary blood vessels and stagnation of blood within the vessels. Cutis marmorata generally occurs on the legs, arms and trunk and is often more severe in cold weather. Evidence: TAS. Frequency: Frequent (HP:0040282). (ORPHA:818)
- Cutaneous photosensitivity (HP:0000992): An increased sensitivity of the skin to light. Photosensitivity may result in a rash upon exposure to the sun (which is known as photodermatosis). Photosensitivity can be diagnosed by phototests in which light is shone on small areas of skin. Evidence: TAS. Frequency: Frequent (HP:0040282). (ORPHA:818)
- Facial capillary hemangioma (HP:0000996): Hemangioma, a benign tumor of the vascular endothelial cells with small endothelial spaces, occurring in the face. Evidence: TAS. Frequency: Frequent (HP:0040282). (ORPHA:818)
- Postaxial hand polydactyly (HP:0001162): Supernumerary digits located at the ulnar side of the hand (that is, on the side with the fifth finger). Evidence: TAS. Frequency: Frequent (HP:0040282). (ORPHA:818)
- Excessive daytime somnolence (HP:0001262): A state of abnormally strong desire for sleep during the daytime. Evidence: TAS. Frequency: Frequent (HP:0040282). (ORPHA:818)
- Intrauterine growth retardation (HP:0001511): An abnormal restriction of fetal growth with fetal weight below the tenth percentile for gestational age. Evidence: TAS. Frequency: Frequent (HP:0040282). (ORPHA:818)
- Polyhydramnios (HP:0001561): The presence of excess amniotic fluid in the uterus during pregnancy. Evidence: TAS. Frequency: Frequent (HP:0040282). (ORPHA:818)
- Abnormality of the larynx (HP:0001600): An abnormality of the larynx. Evidence: TAS. Frequency: Frequent (HP:0040282). (ORPHA:818)
- Ventricular septal defect (HP:0001629): A hole between the two bottom chambers (ventricles) of the heart. The defect is centered around the most superior aspect of the ventricular septum. Evidence: TAS. Frequency: Frequent (HP:0040282). (ORPHA:818)
- Atrial septal defect (HP:0001631): Atrial septal defect (ASD) is a congenital abnormality of the interatrial septum that enables blood flow between the left and right atria via the interatrial septum. Evidence: TAS. Frequency: Frequent (HP:0040282). (ORPHA:818)
- Postaxial foot polydactyly (HP:0001830): Polydactyly of the foot most commonly refers to the presence of six toes on one foot. Postaxial polydactyly affects the lateral ray and the duplication may range from a well-formed articulated digit to a rudimentary digit. Evidence: TAS. Frequency: Frequent (HP:0040282). (ORPHA:818)
- Pulmonary hypoplasia (HP:0002089). Evidence: TAS. Frequency: Frequent (HP:0040282). (ORPHA:818)
- Abnormal lung lobation (HP:0002101): A developmental defect in the formation of pulmonary lobes. Evidence: TAS. Frequency: Frequent (HP:0040282). (ORPHA:818)
- Ventriculomegaly (HP:0002119): An increase in size of the ventricular system of the brain. Evidence: TAS. Frequency: Frequent (HP:0040282). (ORPHA:818)
- Sleep disturbance (HP:0002360): An abnormal pattern in the quality, quantity, or characteristics of sleep. Evidence: TAS. Frequency: Frequent (HP:0040282). (ORPHA:818)
- Recurrent infections (HP:0002719): Increased susceptibility to infections as manifested by repeated bouts of infection. Evidence: TAS. Frequency: Frequent (HP:0040282). (ORPHA:818)
- Tracheal stenosis (HP:0002777). Evidence: TAS. Frequency: Frequent (HP:0040282). (ORPHA:818)
- Hip dislocation (HP:0002827): Displacement of the femur from its normal location in the hip joint. Evidence: TAS. Frequency: Frequent (HP:0040282). (ORPHA:818)
- Biparietal narrowing (HP:0004422): A narrowing of the biparietal diameter (i.e., of the transverse distance between the protuberances of the two parietal bones of the skull). Evidence: TAS. Frequency: Frequent (HP:0040282). (ORPHA:818)
- Abnormal metacarpal morphology (HP:0005916): Any abnormal shape or structure of the metacarpal bones. Evidence: TAS. Frequency: Frequent (HP:0040282). (ORPHA:818)
- Wide intermamillary distance (HP:0006610): A larger than usual distance between the left and right nipple. Evidence: TAS. Frequency: Frequent (HP:0040282). (ORPHA:818)
- Atrioventricular canal defect (HP:0006695): A defect of the atrioventricular septum of the heart. Evidence: TAS. Frequency: Frequent (HP:0040282). (ORPHA:818)
- Attention deficit hyperactivity disorder (HP:0007018): Attention deficit hyperactivity disorder (ADHD) manifests at age 2-3 years or by first grade at the latest. The main symptoms are distractibility, impulsivity, hyperactivity, and often trouble organizing tasks and projects, difficulty going to sleep, and social problems from being aggressive, loud, or impatient. Evidence: TAS. Frequency: Frequent (HP:0040282). (ORPHA:818)
- Aplasia/Hypoplasia of the cerebellum (HP:0007360). Evidence: TAS. Frequency: Frequent (HP:0040282). (ORPHA:818)
- Clitoral hypertrophy (HP:0008665): Hypertrophy of the clitoris. Evidence: TAS. Frequency: Frequent (HP:0040282). (ORPHA:818)
- Hypoplasia of penis (HP:0008736). Evidence: TAS. Frequency: Frequent (HP:0040282). (ORPHA:818)
- Proximal placement of thumb (HP:0009623): Proximal mislocalization of the thumb. Evidence: TAS. Frequency: Frequent (HP:0040282). (ORPHA:818)
- Abnormal cardiovascular system morphology (HP:0030680): Any structural anomaly of the heart and blood vessels. Evidence: TAS. Frequency: Frequent (HP:0040282). (ORPHA:818)
- Self-injurious behavior (HP:0100716): Self-aggression. Evidence: TAS. Frequency: Frequent (HP:0040282). (ORPHA:818)
- Multicystic kidney dysplasia (HP:0000003): Multicystic dysplasia of the kidney is characterized by multiple cysts of varying size in the kidney and the absence of a normal pelvicaliceal system. The condition is associated with ureteral or ureteropelvic atresia, and the affected kidney is nonfunctional. Evidence: TAS. Frequency: Occasional (HP:0040283). (ORPHA:818)
- Ureteropelvic junction obstruction (HP:0000074): Blockage of urine flow from the renal pelvis to the proximal ureter. Evidence: TAS. Frequency: Occasional (HP:0040283). (ORPHA:818)
- Hydronephrosis (HP:0000126): Severe distention of the kidney with dilation of the renal pelvis and calices. Evidence: TAS. Frequency: Occasional (HP:0040283). (ORPHA:818)
- Microglossia (HP:0000171): Decreased length and width of the tongue. Evidence: TAS. Frequency: Occasional (HP:0040283). (ORPHA:818)
- Epicanthus (HP:0000286): A fold of skin starting above the medial aspect of the upper eyelid and arching downward to cover, pass in front of and lateral to the medial canthus. Evidence: TAS. Frequency: Occasional (HP:0040283). (ORPHA:818)
- Hypertelorism (HP:0000316): Interpupillary distance more than 2 SD above the mean (alternatively, the appearance of an increased interpupillary distance or widely spaced eyes). Evidence: TAS. Frequency: Occasional (HP:0040283). (ORPHA:818)
- Sensorineural hearing impairment (HP:0000407): A type of hearing impairment in one or both ears related to an abnormal functionality of the cochlear nerve. Evidence: TAS. Frequency: Occasional (HP:0040283). (ORPHA:818)
- Choanal atresia (HP:0000453): Absence or abnormal closure of the choana (the posterior nasal aperture). Most embryologists believe that posterior choanal atresia results from a failure of rupture between the 35th and 38th day of fetal life of the partition which separates the bucconasal or buccopharyngeal membranes. The resultant choanal atresia may be unilateral or bilateral, bony or membranous, complete or incomplete. In over 90 per cent of cases the obstruction is bony, while in the remainder it is membranous. The bony type of atresia is commonly located 1-2 mm. anterior to the posterior edge of the hard palate, and the osseous septum varies in thickness from 1 to 10 mm. In the membranous form of choanal atresia the obstruction usually occurs further posteriorly. In approximately one third of cases the atresia is bilateral. Evidence: TAS. Frequency: Occasional (HP:0040283). (ORPHA:818)
- Strabismus (HP:0000486): A misalignment of the eyes so that the visual axes deviate from bifoveal fixation. The classification of strabismus may be based on a number of features including the relative position of the eyes, whether the deviation is latent or manifest, intermittent or constant, concomitant or otherwise and according to the age of onset and the relevance of any associated refractive error. Evidence: TAS. Frequency: Occasional (HP:0040283). (ORPHA:818)
- Downslanted palpebral fissures (HP:0000494): The palpebral fissure inclination is more than two standard deviations below the mean. Evidence: TAS. Frequency: Occasional (HP:0040283). (ORPHA:818)
- Abnormal eyelash morphology (HP:0000499): An abnormality of the eyelashes. Evidence: TAS. Frequency: Occasional (HP:0040283). (ORPHA:818)
- Glaucoma (HP:0000501): Glaucoma refers loss of retinal ganglion cells in a characteristic pattern of optic neuropathy usually associated with increased intraocular pressure. Evidence: TAS. Frequency: Occasional (HP:0040283). (ORPHA:818)
- Cataract (HP:0000518): A cataract is an opacity or clouding that develops in the crystalline lens of the eye or in its capsule. Evidence: TAS. Frequency: Occasional (HP:0040283). (ORPHA:818)
- Proptosis (HP:0000520): An eye that is protruding anterior to the plane of the face to a greater extent than is typical. Evidence: TAS. Frequency: Occasional (HP:0040283). (ORPHA:818)
- Upslanted palpebral fissure (HP:0000582): The palpebral fissure inclination is more than two standard deviations above the mean for age (objective); or, the inclination of the palpebral fissure is greater than typical for age. Evidence: TAS. Frequency: Occasional (HP:0040283). (ORPHA:818)
- Iris coloboma (HP:0000612): A coloboma of the iris. Evidence: TAS. Frequency: Occasional (HP:0040283). (ORPHA:818)
- Nystagmus (HP:0000639): Rhythmic, involuntary oscillations of one or both eyes related to abnormality in fixation, conjugate gaze, or vestibular mechanisms. Evidence: TAS. Frequency: Occasional (HP:0040283). (ORPHA:818)
- Sclerocornea (HP:0000647): A congenital anomaly in which a part or the whole of the cornea acquires the characteristics of sclera, resulting in clouding of the cornea. Evidence: TAS. Frequency: Occasional (HP:0040283). (ORPHA:818)
- Optic atrophy (HP:0000648): Atrophy of the optic nerve. Optic atrophy results from the death of the retinal ganglion cell axons that comprise the optic nerve and manifesting as a pale optic nerve on fundoscopy. Evidence: TAS. Frequency: Occasional (HP:0040283). (ORPHA:818)
- Abnormal dental enamel morphology (HP:0000682): An abnormality of the dental enamel. Evidence: TAS. Frequency: Occasional (HP:0040283). (ORPHA:818)
- Abnormal rib morphology (HP:0000772): An anomaly of the rib. Evidence: TAS. Frequency: Occasional (HP:0040283). (ORPHA:818)
- Congenital diaphragmatic hernia (HP:0000776): The presence of a hernia of the diaphragm present at birth. Evidence: TAS. Frequency: Occasional (HP:0040283). (ORPHA:818)
- Brachydactyly (HP:0001156): Digits that appear disproportionately short compared to the hand/foot. The word brachydactyly is used here to describe a series distinct patterns of shortened digits (brachydactyly types A-E). This is the sense used here. Evidence: TAS. Frequency: Occasional (HP:0040283). (ORPHA:818)
- Split hand (HP:0001171): A condition in which middle parts of the hand (fingers and metacarpals) are missing giving a cleft appearance. The severity is very variable ranging from slightly hypoplastic middle fingers over absent middle fingers as far as oligo- or monodactyl hands. Evidence: TAS. Frequency: Occasional (HP:0040283). (ORPHA:818)
- Seizure (HP:0001250): A seizure is an intermittent abnormality of nervous system physiology characterized by a transient occurrence of signs and/or symptoms due to abnormal excessive or synchronous neuronal activity in the brain. Evidence: TAS. Frequency: Occasional (HP:0040283). (ORPHA:818)
- Hypertonia (HP:0001276): A condition in which there is increased muscle tone so that arms or legs, for example, are stiff and difficult to move. Evidence: TAS. Frequency: Occasional (HP:0040283). (ORPHA:818)
- Holoprosencephaly (HP:0001360): Holoprosencephaly is a structural anomaly of the brain in which the developing forebrain fails to divide into two separate hemispheres and ventricles. Evidence: TAS. Frequency: Occasional (HP:0040283). (ORPHA:818)
- Gastroschisis (HP:0001543): A type of congenital ventral incomplete closure of the abdominal wall in which the intestines and sometimes other organs extend freely into the amniotic fluid space through a small opening in the abdomen, usually to the right of the umbilicus. Evidence: TAS. Frequency: Occasional (HP:0040283). (ORPHA:818)
- Patent ductus arteriosus (HP:0001643): In utero, the ductus arteriosus (DA) serves to divert ventricular output away from the lungs and toward the placenta by connecting the main pulmonary artery to the descending aorta. A patent ductus arteriosus (PDA) in the first 3 days of life is a physiologic shunt in healthy term and preterm newborn infants, and normally is substantially closed within about 24 hours after bith and completely closed after about three weeks. Failure of physiologcal closure is referred to a persistent or patent ductus arteriosus (PDA). Depending on the degree of left-to-right shunting, PDA can have clinical consequences. Evidence: TAS. Frequency: Occasional (HP:0040283). (ORPHA:818)
- Talipes calcaneovalgus (HP:0001884): Talipes calcaneovalgus is a flexible foot deformity (as opposed to a rigid congenital vertical talus foot deformity) that can either present as a positional or structural foot deformity depending on severity and/or causality. The axis of calcaneovalgus deformity is in the tibiotalar joint, where the foot is positioned in extreme hyperextension. On inspection, the foot has an "up and out" appearance, with the dorsal forefoot practically touching the anterior aspect of the ankle and lower leg. Evidence: TAS. Frequency: Occasional (HP:0040283). (ORPHA:818)
- Pyloric stenosis (HP:0002021): Pyloric stenosis, also known as infantile hypertrophic pyloric stenosis, is an uncommon condition in infants characterized by abnormal thickening of the pylorus muscles in the stomach leading to gastric outlet obstruction. Clinically infants are well at birth. Then, at 3 to 6 weeks of age, the infants present with projectile vomiting, potentially leading to dehydration and weight loss. Evidence: TAS. Frequency: Occasional (HP:0040283). (ORPHA:818)
- Aganglionic megacolon (HP:0002251): An abnormality resulting from a lack of intestinal ganglion cells (i.e., an aganglionic section of bowel) that results in bowel obstruction with enlargement of the colon. Evidence: TAS. Frequency: Occasional (HP:0040283). (ORPHA:818)
- Scoliosis (HP:0002650): The presence of an abnormal lateral curvature of the spine. Evidence: TAS. Frequency: Occasional (HP:0040283). (ORPHA:818)
- Kyphosis (HP:0002808): Exaggerated anterior convexity of the thoracic vertebral column. Evidence: TAS. Frequency: Occasional (HP:0040283). (ORPHA:818)
- Mesomelia (HP:0003027): Shortening of the middle parts of the limbs (forearm and lower leg) in relation to the upper and terminal segments. Evidence: TAS. Frequency: Occasional (HP:0040283). (ORPHA:818)
- Abnormal vertebral body morphology (HP:0003312): Abnormal form of vertebral body, which is the central cylindrical portion of the vertebra that together with other structures such as the vertebral arch, pedicles, laminae, spinous process, transverse processes, and articular facets makes up a vertebra. Evidence: TAS. Frequency: Occasional (HP:0040283). (ORPHA:818)
- Abnormality of the gallbladder (HP:0005264): An abnormality of the gallbladder. Evidence: TAS. Frequency: Occasional (HP:0040283). (ORPHA:818)
- Hypopigmentation of hair (HP:0005599). Evidence: TAS. Frequency: Occasional (HP:0040283). (ORPHA:818)
- Finger syndactyly (HP:0006101): Webbing or fusion of the fingers, involving soft parts only or including bone structure. Bony fusions are referred to as "bony" Syndactyly if the fusion occurs in a radio-ulnar axis. Fusions of bones of the fingers in a proximo-distal axis are referred to as "Symphalangism". Evidence: TAS. Frequency: Occasional (HP:0040283). (ORPHA:818)
- Advanced eruption of teeth (HP:0006288): Premature tooth eruption, which can be defined as tooth eruption more than 2 SD earlier than the mean eruption age. Evidence: TAS. Frequency: Occasional (HP:0040283). (ORPHA:818)
- Aplasia/Hypoplasia of the radius (HP:0006501): A small/hypoplastic or absent/aplastic radius. Evidence: TAS. Frequency: Occasional (HP:0040283). (ORPHA:818)
- Aplasia/Hypoplasia of the corpus callosum (HP:0007370): Absence or underdevelopment of the corpus callosum. Evidence: TAS. Frequency: Occasional (HP:0040283). (ORPHA:818)
- Aplasia/Hypoplasia affecting the eye (HP:0008056). Evidence: TAS. Frequency: Occasional (HP:0040283). (ORPHA:818)
- Renal hypoplasia/aplasia (HP:0008678): Absence or underdevelopment of the kidney. Evidence: TAS. Frequency: Occasional (HP:0040283). (ORPHA:818)
- Rhizomelia (HP:0008905): Disproportionate shortening of the proximal segment of limbs (i.e. the femur and humerus). Evidence: TAS. Frequency: Occasional (HP:0040283). (ORPHA:818)
- Ulnar deviation of finger (HP:0009465): Bending or curvature of a finger toward the ulnar side (i.e., away from the thumb). The deviation is at the metacarpal-phalangeal joint, and this finding is distinct from clinodactyly. Evidence: TAS. Frequency: Occasional (HP:0040283). (ORPHA:818)
- Tooth agenesis (HP:0009804): The absence of one or more teeth from the normal series by a failure to develop. Evidence: TAS. Frequency: Occasional (HP:0040283). (ORPHA:818)
- Bifid tongue (HP:0010297): Tongue with a median apical indentation or fork. Evidence: TAS. Frequency: Occasional (HP:0040283). (ORPHA:818)
- Supernumerary tooth (HP:0011069): The presence of one or more teeth additional to the normal number. Evidence: TAS. Frequency: Occasional (HP:0040283). (ORPHA:818)
- Abnormal localization of kidney (HP:0100542): An abnormal site of the kidney. Evidence: TAS. Frequency: Occasional (HP:0040283). (ORPHA:818)
- Posteriorly rotated ears (HP:0000358): A type of abnormal location of the ears in which the position of the ears is characterized by posterior rotation (the superior part of the ears is rotated towards the back of the head, and the inferior part of the ears towards the front). Evidence: TAS. Frequency: Frequent (HP:0040282). (ORPHA:818)
These phenotypes are associated with the disease Smith-Lemli-Opitz syndrome (ORPHA:818).